- Bilateral tonic-clonic seizure (HP:0002069): A bilateral tonic-clonic seizure is a seizure defined by a tonic (bilateral increased tone, lasting seconds to minutes) and then a clonic (bilateral sustained rhythmic jerking) phase. Evidence: IEA. (OMIM:602477)
- Febrile seizure (within the age range of 3 months to 6 years) (HP:0002373): A febrile seizure is any type of seizure (most often a generalized tonic-clonic seizure) occurring with fever (at least 38 degrees Celsius) but in the absence of central nervous system infection, severe metabolic disturbance or other alternative precipitant in children between the ages of 3 months and 6 years. Evidence: TAS. (OMIM:602477)
- Atonic seizure (HP:0010819): Atonic seizure is a type of motor seizure characterized by a sudden loss or diminution of muscle tone without apparent preceding myoclonic or tonic event lasting about 1 to 2 seconds, involving head, trunk, jaw, or limb musculature. Evidence: TAS. (OMIM:602477)
- Generalized tonic seizure (HP:0010818): A generalized tonic seizure is a type of generalized motor seizure characterized by bilateral limb stiffening or elevation, often with neck stiffening without a subsequent clonic phase. The tonic activity can be a sustained abnormal posture, either in extension or flexion, sometimes accompanied by tremor of the extremities. Evidence: IEA. (OMIM:602477)
- Infantile onset (HP:0003593): Onset of signs or symptoms of disease between 28 days to one year of life. Evidence: TAS. (OMIM:602477)
- Autosomal dominant inheritance (HP:0000006): A mode of inheritance that is observed for traits related to a gene encoded on one of the autosomes (i.e., the human chromosomes 1-22) in which a trait manifests in heterozygotes. In the context of medical genetics, an autosomal dominant disorder is caused when a single copy of the mutant allele is present. Males and females are affected equally, and can both transmit the disorder with a risk of 50% for each child of inheriting the mutant allele. Evidence: PCS. (PMID:20437590)
These phenotypes are associated with the disease epilepsy, idiopathic generalized, susceptibility to, 17 (OMIM:602477).